Phenotypes associated with the disease Blepharophimosis-intellectual disability syndrome, MKB type (ORPHA:293707):
- Coarse facial features (HP:0000280): Absence of fine and sharp appearance of brows, nose, lips, mouth, and chin, usually because of rounded and heavy features or thickened skin with or without thickening of subcutaneous and bony tissues. Evidence: TAS. Frequency: Frequent (HP:0040282). (ORPHA:293707)
- Triangular face (HP:0000325): Facial contour, as viewed from the front, triangular in shape, with breadth at the temples and tapering to a narrow chin. Evidence: TAS. Frequency: Frequent (HP:0040282). (ORPHA:293707)
- Bulbous nose (HP:0000414): Increased volume and globular shape of the anteroinferior aspect of the nose. Evidence: TAS. Frequency: Frequent (HP:0040282). (ORPHA:293707)
- Prominent nose (HP:0000448): Distance between subnasale and pronasale more than two standard deviations above the mean, or alternatively, an apparently increased anterior protrusion of the nasal tip. Evidence: TAS. Frequency: Frequent (HP:0040282). (ORPHA:293707)
- Blepharophimosis (HP:0000581): A fixed reduction in the vertical distance between the upper and lower eyelids with short palpebral fissures. Evidence: TAS. Frequency: Frequent (HP:0040282). (ORPHA:293707)
- Intellectual disability (HP:0001249): The term intellectual disability or intellectual developmental disorder is used to describe significantly sub-average intellectual and adaptive functioning based on clinical assessment and as measured by individually administered, appropriately normed, standardized and validated tests of intellectual functioning and adaptive behavior, with onset during the developmental period from infancy through adolescence. Evidence: TAS. Frequency: Frequent (HP:0040282). (ORPHA:293707)
- Floppy infant (HP:0008947): Floppiness/hypotonia is defined as reduced resistance to passive movement of joints. Physical examination of floppy/hypotonic infants shows head lag, lack of shoulder and elbow muscle contraction on traction response, inability to tighten the shoulder girdle muscles (or slipping through) when held under the axillae, scarf sign (when the arm is pulled to the opposite side, the arm wraps around the neck with the elbow crossing midline), hyperdorsiflexion of the feet, easy apposition of the thumb against the forearm, feet touching the cheek with ease and without discomfort, frog leg position, and inverted U sign on ventral suspension (head, arms, and legs hanging down without elbow or knee flexion and the trunk rounded in a dome shape). Evidence: TAS. Frequency: Frequent (HP:0040282). (ORPHA:293707)
- Thick nasal alae (HP:0009928): Increase in bulk of the ala nasi. Evidence: TAS. Frequency: Frequent (HP:0040282). (ORPHA:293707)